Phenotypes associated with the disease microphthalmia, isolated, with cataract 1 (OMIM:156850):
- Strabismus (HP:0000486): A misalignment of the eyes so that the visual axes deviate from bifoveal fixation. The classification of strabismus may be based on a number of features including the relative position of the eyes, whether the deviation is latent or manifest, intermittent or constant, concomitant or otherwise and according to the age of onset and the relevance of any associated refractive error. Evidence: IEA. (OMIM:156850)
- Cataract (HP:0000518): A cataract is an opacity or clouding that develops in the crystalline lens of the eye or in its capsule. Evidence: IEA. (OMIM:156850)
- Nystagmus (HP:0000639): Rhythmic, involuntary oscillations of one or both eyes related to abnormality in fixation, conjugate gaze, or vestibular mechanisms. Evidence: IEA. (OMIM:156850)
- Miosis (HP:0000616): Abnormal (non-physiological) constriction of the pupil. Evidence: IEA. (OMIM:156850)
- Microphthalmia (HP:0000568): A developmental anomaly characterized by abnormal smallness of one or both eyes. Evidence: IEA. (OMIM:156850)
- Autosomal dominant inheritance (HP:0000006): A mode of inheritance that is observed for traits related to a gene encoded on one of the autosomes (i.e., the human chromosomes 1-22) in which a trait manifests in heterozygotes. In the context of medical genetics, an autosomal dominant disorder is caused when a single copy of the mutant allele is present. Males and females are affected equally, and can both transmit the disorder with a risk of 50% for each child of inheriting the mutant allele. Evidence: IEA. (OMIM:156850)